Phenotypes associated with the disease Fryns-Smeets-Thiry syndrome (ORPHA:2058):
- Wide mouth (HP:0000154): Distance between the oral commissures more than 2 SD above the mean. Alternatively, an apparently increased width of the oral aperture (subjective). Evidence: TAS. Frequency: Very frequent (HP:0040281). (ORPHA:2058)
- Thick lower lip vermilion (HP:0000179): Increased thickness of the lower lip, leading to a prominent appearance of the lower lip. The height of the vermilion of the lower lip in the midline is more than 2 SD above the mean. Alternatively, an apparently increased height of the vermilion of the lower lip in the frontal view (subjective). Evidence: TAS. Frequency: Very frequent (HP:0040281). (ORPHA:2058)
- Everted lower lip vermilion (HP:0000232): An abnormal configuration of the lower lip such that it is turned outward i.e., everted, with the Inner aspect of the lower lip vermilion (normally opposing the teeth) being visible in a frontal view. Evidence: TAS. Frequency: Very frequent (HP:0040281). (ORPHA:2058)
- Microcephaly (HP:0000252): Head circumference below 2 standard deviations below the mean for age and gender. Evidence: TAS. Frequency: Very frequent (HP:0040281). (ORPHA:2058)
- Short philtrum (HP:0000322): Distance between nasal base and midline upper lip vermilion border more than 2 SD below the mean. Alternatively, an apparently decreased distance between nasal base and midline upper lip vermilion border. Evidence: TAS. Frequency: Very frequent (HP:0040281). (ORPHA:2058)
- Micrognathia (HP:0000347): Developmental hypoplasia of the mandible. Evidence: TAS. Frequency: Very frequent (HP:0040281). (ORPHA:2058)
- Prominent nasal bridge (HP:0000426): Anterior positioning of the nasal root in comparison to the usual positioning for age. Evidence: TAS. Frequency: Very frequent (HP:0040281). (ORPHA:2058)
- Narrow nasal bridge (HP:0000446): Decreased width of the bony bridge of the nose. Evidence: TAS. Frequency: Very frequent (HP:0040281). (ORPHA:2058)
- Arachnodactyly (HP:0001166): Abnormally long and slender fingers (spider fingers). Evidence: TAS. Frequency: Very frequent (HP:0040281). (ORPHA:2058)
- Intellectual disability (HP:0001249): The term intellectual disability or intellectual developmental disorder is used to describe significantly sub-average intellectual and adaptive functioning based on clinical assessment and as measured by individually administered, appropriately normed, standardized and validated tests of intellectual functioning and adaptive behavior, with onset during the developmental period from infancy through adolescence. Evidence: TAS. Frequency: Very frequent (HP:0040281). (ORPHA:2058)
- Hypotonia (HP:0001252): Hypotonia is an abnormally low muscle tone (the amount of tension or resistance to movement in a muscle). Even when relaxed, muscles have a continuous and passive partial contraction which provides some resistance to passive stretching. Hypotonia thus manifests as diminished resistance to passive stretching. Hypotonia is not the same as muscle weakness, although the two conditions can co-exist. Evidence: TAS. Frequency: Very frequent (HP:0040281). (ORPHA:2058)
- Disproportionate tall stature (HP:0001519): A tall and slim body build with increased arm span to height ratio (>1.05) and a reduced upper-to-lower segment ratio (<0.85), i.e., unusually long arms and legs. The extremities as well as the hands and feet are unusually slim. Evidence: TAS. Frequency: Very frequent (HP:0040281). (ORPHA:2058)
- Scoliosis (HP:0002650): The presence of an abnormal lateral curvature of the spine. Evidence: TAS. Frequency: Very frequent (HP:0040281). (ORPHA:2058)
- Downturned corners of mouth (HP:0002714): A morphological abnormality of the mouth in which the angle of the mouth is downturned. The oral commissures are positioned inferior to the midline labial fissure. Evidence: TAS. Frequency: Very frequent (HP:0040281). (ORPHA:2058)
- Hip dislocation (HP:0002827): Displacement of the femur from its normal location in the hip joint. Evidence: TAS. Frequency: Very frequent (HP:0040281). (ORPHA:2058)
- Short stature (HP:0004322): A height below that which is expected according to age and gender norms. Although there is no universally accepted definition of short stature, many refer to "short stature" as height more than 2 standard deviations below the mean for age and gender (or below the 3rd percentile for age and gender dependent norms). Evidence: TAS. Frequency: Very frequent (HP:0040281). (ORPHA:2058)
- Cachexia (HP:0004326): Severe weight loss, wasting of muscle, loss of appetite, and general debility related to a chronic disease. Evidence: TAS. Frequency: Very frequent (HP:0040281). (ORPHA:2058)
- Patellar aplasia (HP:0006443): Absence of the patella. Evidence: TAS. Frequency: Very frequent (HP:0040281). (ORPHA:2058)
- Joint hypermobility (HP:0001382): The capability that a joint (or a group of joints) has to move, passively and/or actively, beyond normal limits along physiological axes. Evidence: TAS. Frequency: Very frequent (HP:0040281). (ORPHA:2058)